- Abdominal pain (HP:0002027): An unpleasant sensation characterized by physical discomfort (such as pricking, throbbing, or aching) and perceived to originate in the abdomen. Evidence: TAS. Frequency: Very frequent (HP:0040281). (ORPHA:469)
- Reduced circulating aldolase concentration (HP:0012545): Concentration of fructose 1,6-bisphosphate aldolase in the blood circulation below the lower limit of normal. Evidence: TAS. Frequency: Very frequent (HP:0040281). (ORPHA:469)
- Growth delay (HP:0001510): A deficiency or slowing down of growth pre- and postnatally. Evidence: TAS. Frequency: Frequent (HP:0040282). (ORPHA:469)
- Diarrhea (HP:0002014): Abnormally increased frequency (usually defined as three or more) loose or watery bowel movements a day. Evidence: TAS. Frequency: Frequent (HP:0040282). (ORPHA:469)
- Nausea (HP:0002018): A sensation of unease in the stomach together with an urge to vomit. Evidence: TAS. Frequency: Frequent (HP:0040282). (ORPHA:469)
- Renal insufficiency (HP:0000083): A reduction in the level of performance of the kidneys in areas of function comprising the concentration of urine, removal of wastes, the maintenance of electrolyte balance, homeostasis of blood pressure, and calcium metabolism. Evidence: TAS. Frequency: Occasional (HP:0040283). (ORPHA:469)
- Jaundice (HP:0000952): Yellow pigmentation of the skin due to bilirubin, which in turn is the result of increased bilirubin concentration in the bloodstream. Evidence: TAS. Frequency: Occasional (HP:0040283). (ORPHA:469)
- Episodic hyperhidrosis (HP:0001069): Intermittent episodes of abnormally increased perspiration. Evidence: TAS. Frequency: Occasional (HP:0040283). (ORPHA:469)
- Metabolic acidosis (HP:0001942): Metabolic acidosis (MA) is characterized by a fall in blood pH due to a reduction of serum bicarbonate concentration. This can occur as a result of either the accumulation of acids (high anion gap MA) or the loss of bicarbonate from the gastrointestinal tract or the kidney (hyperchloremic MA). By definition, MA is not due to a respirary cause. Evidence: TAS. Frequency: Occasional (HP:0040283). (ORPHA:469)
- Vomiting (HP:0002013): Forceful ejection of the contents of the stomach through the mouth by means of a series of involuntary spasmic contractions. Evidence: TAS. Frequency: Occasional (HP:0040283). (ORPHA:469)
- Constipation (HP:0002019): Infrequent or difficult evacuation of feces. Evidence: TAS. Frequency: Occasional (HP:0040283). (ORPHA:469)
- Hypophosphatemia (HP:0002148): The concentration of phosphate ion in the blood circulation is below the lower limit of normal. Evidence: TAS. Frequency: Occasional (HP:0040283). (ORPHA:469)
- Hyperuricemia (HP:0002149): The concentration of uric acid in the blood circulation is above the upper limit of normal. Evidence: TAS. Frequency: Occasional (HP:0040283). (ORPHA:469)
- Hepatomegaly (HP:0002240): Abnormally increased size of the liver. Evidence: TAS. Frequency: Occasional (HP:0040283). (ORPHA:469)
- Hypermagnesemia (HP:0002918): The concentration of magnesium in the blood circulation is above the upper limit of normal. Evidence: TAS. Frequency: Occasional (HP:0040283). (ORPHA:469)
- Abnormality of the coagulation cascade (HP:0003256): An abnormality of the coagulation cascade, which is comprised of the contact activation pathway (also known as the intrinsic pathway) and the tissue factor pathway (also known as the extrinsic pathway) as well as cofactors and regulators. Evidence: TAS. Frequency: Occasional (HP:0040283). (ORPHA:469)
- Abdominal distention (HP:0003270): Distention of the abdomen. Evidence: TAS. Frequency: Occasional (HP:0040283). (ORPHA:469)
- Reactive hypoglycemia (HP:0012051): Hypoglycermia following a meal (or more generally, after intake of glucose). Evidence: TAS. Frequency: Occasional (HP:0040283). (ORPHA:469)
- Chronic kidney disease (HP:0012622): Functional anomaly of the kidney persisting for at least three months. Evidence: TAS. Frequency: Occasional (HP:0040283). (ORPHA:469)
- Chronic hepatic failure (HP:0100626). Evidence: TAS. Frequency: Occasional (HP:0040283). (ORPHA:469)
- Cataract (HP:0000518): A cataract is an opacity or clouding that develops in the crystalline lens of the eye or in its capsule. Evidence: TAS. Frequency: Very rare (HP:0040284). (ORPHA:469)
- Seizure (HP:0001250): A seizure is an intermittent abnormality of nervous system physiology characterized by a transient occurrence of signs and/or symptoms due to abnormal excessive or synchronous neuronal activity in the brain. Evidence: TAS. Frequency: Very rare (HP:0040284). (ORPHA:469)
- Lethargy (HP:0001254): A state of fatigue, either physical or mental slowness and sluggishness, with difficulties in initiating or performing simple tasks. Distinguished from apathy which implies indifference and a lack of desire or interest in the task. A person with lethargy may have the desire, but not the energy to engage in personal or socially relevant tasks. Evidence: TAS. Frequency: Very rare (HP:0040284). (ORPHA:469)
- Coma (HP:0001259): The complete absence of wakefulness and consciousness, which is evident through a lack of response to any form of external stimuli. Evidence: TAS. Frequency: Very rare (HP:0040284). (ORPHA:469)
These phenotypes are associated with the disease Hereditary fructose intolerance (ORPHA:469).